- Expressive language delay (HP:0002474): A delay in the acquisition of the ability to use language to communicate needs, wishes, or thoughts. Evidence: TAS. (OMIM:600117)
- Aphasia (HP:0002381): An acquired language impairment of some or all of the abilities to produce or comprehend speech and to read or write. Evidence: TAS. (OMIM:600117)
- Autosomal dominant inheritance (HP:0000006): A mode of inheritance that is observed for traits related to a gene encoded on one of the autosomes (i.e., the human chromosomes 1-22) in which a trait manifests in heterozygotes. In the context of medical genetics, an autosomal dominant disorder is caused when a single copy of the mutant allele is present. Males and females are affected equally, and can both transmit the disorder with a risk of 50% for each child of inheriting the mutant allele. Evidence: IEA. (OMIM:600117)
These phenotypes are associated with the disease familial developmental dysphasia (OMIM:600117).